Phenotypes associated with the disease nephrotic syndrome, IIa 26 (OMIM:620049):
- Stage 5 chronic kidney disease (HP:0003774): A degree of kidney failure severe enough to require dialysis or kidney transplantation for survival characterized by a severe reduction in glomerular filtration rate (less than 15 ml/min/1.73 m2) and other manifestations including increased serum creatinine. Evidence: PCS. Frequency: 1/6. (PMID:29534211)
- Nephrotic syndrome (HP:0000100): Nephrotic syndrome is a collection of findings resulting from glomerular dysfunction with an increase in glomerular capillary wall permeability associated with pronounced proteinuria. Nephrotic syndrome refers to the constellation of clinical findings that result from severe renal loss of protein, with Proteinuria and hypoalbuminemia, edema, and hyperlipidemia. Evidence: PCS. Frequency: 6/6. Onset: Childhood onset (HP:0011463). (PMID:29534211)
- Childhood onset (HP:0011463): Onset of disease at the age of between 1 and 5 years. Evidence: PCS. Frequency: 6/6. (PMID:29534211)
- Focal segmental glomerulosclerosis (HP:0000097): Segmental accumulation of scar tissue in individual (but not all) glomeruli. Evidence: PCS. Frequency: 2/2. (PMID:29534211)
- Autosomal recessive inheritance (HP:0000007): A mode of inheritance that is observed for traits related to a gene encoded on one of the autosomes (i.e., the human chromosomes 1-22) in which a trait manifests in individuals with two pathogenic alleles, either homozygotes (two copies of the same mutant allele) or compound heterozygotes (whereby each copy of a gene has a distinct mutant allele). Evidence: PCS. (PMID:29534211)
- Steroid-resistant nephrotic syndrome (HP:0012588): A form of nephrotic syndrome that does not respond to treatment with steroid medication, defined as persistent proteinuria despite 60mg/m2 or 2mg/kg for 8 weeks, after insuring no infection or non-adherence to medication. Evidence: PCS. Frequency: 2/6. (PMID:29534211)